- Sensorineural hearing impairment (HP:0000407): A type of hearing impairment in one or both ears related to an abnormal functionality of the cochlear nerve. Evidence: IEA. (OMIM:610220)
- Autosomal recessive inheritance (HP:0000007): A mode of inheritance that is observed for traits related to a gene encoded on one of the autosomes (i.e., the human chromosomes 1-22) in which a trait manifests in individuals with two pathogenic alleles, either homozygotes (two copies of the same mutant allele) or compound heterozygotes (whereby each copy of a gene has a distinct mutant allele). Evidence: IEA. (OMIM:610220)
These phenotypes are associated with the disease autosomal recessive nonsyndromic hearing loss 59 (OMIM:610220).